Phenotypes associated with the disease gastric adenocarcinoma and proximal polyposis of the stomach (OMIM:619182):
- Gastric adenocarcinoma (HP:0033770): An adenocarcinoma arising from the stomach glandular epithelium. Gastric carcinoma often produces no specific symptoms when it is superficial and potentially surgically curable, although up to 50% of patients may have nonspecific gastrointestinal complaints such as dyspepsia. Evidence: PCS. Frequency: 17/32. (PMID:27087319;PMID:27343414)
- Melena (HP:0002249): The passage of blackish, tarry feces associated with gastrointestinal hemorrhage. Melena occurs if the blood remains in the colon long enough for it to be broken down by colonic bacteria. One degradation product, hematin, imbues the stool with a blackish color. Thus, melena generally occurs with bleeding from the upper gastrointestinal tract (e.g., stomach ulcers or duodenal ulcers), since the blood usually remains in the gut for a longer period of time than with lower gastrointestinal bleeding. Evidence: PCS. Frequency: 1/5. (PMID:27343414)
- Autosomal dominant inheritance (HP:0000006): A mode of inheritance that is observed for traits related to a gene encoded on one of the autosomes (i.e., the human chromosomes 1-22) in which a trait manifests in heterozygotes. In the context of medical genetics, an autosomal dominant disorder is caused when a single copy of the mutant allele is present. Males and females are affected equally, and can both transmit the disorder with a risk of 50% for each child of inheriting the mutant allele. Evidence: PCS. (PMID:27087319)
- Fundic gland polyposis (HP:0033769): Multiple polyps in the acid-secreting mucosa of the gastric body and fundus. Fundic gland polyps (FGP) are usually 1 to 5 mm in size, though larger polyps have been found. FGPs are typically sessile, shiny, translucent, pale to pinkish in color (resembling the surrounding mucosa), and often exhibit tiny surface blood vessels. These polyps have characteristically been observed to chunk off or detach entirely at the base when removed with cold forceps, in contrast to other types of gastric polyps. Evidence: PCS. Frequency: 32/32. (PMID:27087319;PMID:27343414)
- Abdominal pain (HP:0002027): An unpleasant sensation characterized by physical discomfort (such as pricking, throbbing, or aching) and perceived to originate in the abdomen. Evidence: PCS. Frequency: 2/5. (PMID:27343414)